Phenotypes associated with the disease Paraneoplastic pemphigus (ORPHA:63455):
- Oral ulcer (HP:0000155): Erosion of the mucous mebrane of the mouth with local excavation of the surface, resulting from the sloughing of inflammatory necrotic tissue. Evidence: TAS. Frequency: Very frequent (HP:0040281). (ORPHA:63455)
- Abnormal blistering of the skin (HP:0008066): The presence of one or more bullae on the skin, defined as fluid-filled blisters more than 5 mm in diameter with thin walls. Evidence: TAS. Frequency: Very frequent (HP:0040281). (ORPHA:63455)
- B-cell lymphoma (HP:0012191): A type of lymphoma that originates in B-cells. Evidence: TAS. Frequency: Frequent (HP:0040282). (ORPHA:63455)
- Sarcoma (HP:0100242): A connective tissue neoplasm formed by proliferation of mesodermal cells. Bone and soft tissue sarcomas are the main types of sarcoma. Sarcoma is usually highly malignant. Evidence: TAS. Frequency: Frequent (HP:0040282). (ORPHA:63455)
- Thymoma (HP:0100522): A tumor originating from the epithelial cells of the thymus. Evidence: TAS. Frequency: Frequent (HP:0040282). (ORPHA:63455)
- Skin erosion (HP:0200041): A discontinuity of the skin exhibiting incomplete loss of the epidermis, a lesion that is moist, circumscribed, and usually depressed. Evidence: TAS. Frequency: Very frequent (HP:0040281). (ORPHA:63455)
- Oral mucosal blisters (HP:0200097): Blisters arising in the mouth. Evidence: TAS. Frequency: Very frequent (HP:0040281). (ORPHA:63455)